Phenotypes associated with the disease glycosylphosphatidylinositol biosynthesis defect 15 (OMIM:617810):
- Narrow forehead (HP:0000341): Width of the forehead or distance between the frontotemporales is more than two standard deviations below the mean (objective); or apparently narrow intertemporal region (subjective). Evidence: PCS. Frequency: 4/10. (PMID:29100095)
- Bilateral tonic-clonic seizure (HP:0002069): A bilateral tonic-clonic seizure is a seizure defined by a tonic (bilateral increased tone, lasting seconds to minutes) and then a clonic (bilateral sustained rhythmic jerking) phase. Evidence: PCS. Frequency: 7/10. (PMID:29100095)
- Inability to walk (HP:0002540): Incapability to ambulate. Evidence: PCS. (PMID:29100095)
- Anteverted nares (HP:0000463): Anteriorly-facing nostrils viewed with the head in the Frankfurt horizontal and the eyes of the observer level with the eyes of the subject. This gives the appearance of an upturned nose (upturned nasal tip). Evidence: PCS. Frequency: 4/10. (PMID:29100095)
- Dysmetria (HP:0001310): A type of ataxia characterized by the inability to carry out movements with the correct range and motion across the plane of more than one joint related to incorrect estimation of the distances required for targeted movements. Evidence: PCS. Frequency: 6/6. (PMID:29100095)
- Apraxia (HP:0002186): A defect in the understanding of complex motor commands and in the execution of certain learned movements, i.e., deficits in the cognitive components of learned movements. Evidence: PCS. Frequency: 2/10. (PMID:29100095)
- Cerebellar atrophy (HP:0001272): Cerebellar atrophy is defined as a cerebellum with initially normal structures, in a posterior fossa with normal size, which displays enlarged fissures (interfolial spaces) in comparison to the foliae secondary to loss of tissue. Cerebellar atrophy implies irreversible loss of tissue and result from an ongoing progressive disease until a final stage is reached or a single injury, e.g. an intoxication or infectious event. Evidence: PCS. Frequency: 9/9. (PMID:29100095)
- Gait ataxia (HP:0002066): A type of ataxia characterized by the impairment of the ability to coordinate the movements required for normal walking. Gait ataxia is characteirzed by a wide-based staggering gait with a tendency to fall. Evidence: PCS. Frequency: 7/7. (PMID:29100095)
- Generalized non-motor (absence) seizure (HP:0002121): A generalized non-motor (absence) seizure is a type of a type of dialeptic seizure that is of electrographically generalized onset. It is a generalized seizure characterized by an interruption of activities, a blank stare, and usually the person will be unresponsive when spoken to. Any ictal motor phenomena are minor in comparison to these non-motor features. Evidence: PCS. Frequency: 1/10. (PMID:29100095)
- Hypotonia (HP:0001252): Hypotonia is an abnormally low muscle tone (the amount of tension or resistance to movement in a muscle). Even when relaxed, muscles have a continuous and passive partial contraction which provides some resistance to passive stretching. Hypotonia thus manifests as diminished resistance to passive stretching. Hypotonia is not the same as muscle weakness, although the two conditions can co-exist. Evidence: PCS. Frequency: 10/10. (PMID:29100095)
- Infantile onset (HP:0003593): Onset of signs or symptoms of disease between 28 days to one year of life. Evidence: IEA. (PMID:29100095)
- Myoclonic seizure (HP:0032794): A myoclonic seizure is a type of motor seizure characterized by sudden, brief (<100 ms) involuntary single or multiple contraction of muscles or muscle groups of variable topography (axial, proximal limb, distal). Myoclonus is less regularly repetitive and less sustained than is clonus. Evidence: PCS. Frequency: 4/10. (PMID:29100095)
- Nystagmus (HP:0000639): Rhythmic, involuntary oscillations of one or both eyes related to abnormality in fixation, conjugate gaze, or vestibular mechanisms. Evidence: PCS. Frequency: 8/10. (PMID:29100095)
- Osteopenia (HP:0000938): Osteopenia is a term to define bone density that is not normal but also not as low as osteoporosis. By definition from the World Health Organization osteopenia is defined by bone densitometry as a T score -1 to -2.5. Evidence: PCS. Frequency: 8/8. (PMID:29100095)
- Prominent forehead (HP:0011220): Forward prominence of the entire forehead, due to protrusion of the frontal bone. Evidence: PCS. Frequency: 4/10. (PMID:29100095)
- Intellectual disability (HP:0001249): The term intellectual disability or intellectual developmental disorder is used to describe significantly sub-average intellectual and adaptive functioning based on clinical assessment and as measured by individually administered, appropriately normed, standardized and validated tests of intellectual functioning and adaptive behavior, with onset during the developmental period from infancy through adolescence. Evidence: PCS. (PMID:29100095)
- Hyperreflexia (HP:0001347): Hyperreflexia is the presence of hyperactive stretch reflexes of the muscles. Evidence: PCS. Frequency: 6/10. (PMID:29100095)
- Delayed speech and language development (HP:0000750): A degree of language development that is significantly below the norm for a child of a specified age. Evidence: PCS. Frequency: 7/7. (PMID:29100095)
- EEG abnormality (HP:0002353): Abnormality observed by electroencephalogram (EEG), which is used to record of the brain's spontaneous electrical activity from multiple electrodes placed on the scalp. Evidence: PCS. Frequency: 6/7. (PMID:29100095)
- Cerebellar hypoplasia (HP:0001321): Cerebellar hypoplasia is a descriptive term implying a cerebellum with a reduced volume, but a normal shape and is stable over time. Evidence: PCS. Frequency: 1/10. (PMID:29100095)
- Dysarthria (HP:0001260): Dysarthric speech is a general description referring to a neurological speech disorder characterized by poor articulation. Depending on the involved neurological structures, dysarthria may be further classified as spastic, flaccid, ataxic, hyperkinetic and hypokinetic, or mixed. Evidence: PCS. Frequency: 5/5. (PMID:29100095)
- Atonic seizure (HP:0010819): Atonic seizure is a type of motor seizure characterized by a sudden loss or diminution of muscle tone without apparent preceding myoclonic or tonic event lasting about 1 to 2 seconds, involving head, trunk, jaw, or limb musculature. Evidence: PCS. Frequency: 2/10. (PMID:29100095)
- Global developmental delay (HP:0001263): A delay in the achievement of motor or mental milestones in the domains of development of a child, including motor skills, speech and language, cognitive skills, and social and emotional skills. This term should only be used to describe children younger than five years of age. Evidence: PCS. Frequency: 10/10. (PMID:29100095)
- Autosomal recessive inheritance (HP:0000007): A mode of inheritance that is observed for traits related to a gene encoded on one of the autosomes (i.e., the human chromosomes 1-22) in which a trait manifests in individuals with two pathogenic alleles, either homozygotes (two copies of the same mutant allele) or compound heterozygotes (whereby each copy of a gene has a distinct mutant allele). Evidence: PCS. (PMID:29100095)
- Optic atrophy (HP:0000648): Atrophy of the optic nerve. Optic atrophy results from the death of the retinal ganglion cell axons that comprise the optic nerve and manifesting as a pale optic nerve on fundoscopy. Evidence: PCS. Frequency: 1/10. (PMID:29100095)
- Visual impairment (HP:0000505): Visual impairment (or vision impairment) is vision loss (of a person) to such a degree as to qualify as an additional support need through a significant limitation of visual capability resulting from either disease, trauma, or congenital or degenerative conditions that cannot be corrected by conventional means, such as refractive correction, medication, or surgery. Evidence: PCS. Frequency: 2/10. (PMID:29100095)
- Spasticity (HP:0001257): A motor disorder characterized by a velocity-dependent increase in tonic stretch reflexes with increased muscle tone, exaggerated (hyperexcitable) tendon reflexes. Evidence: PCS. Frequency: 4/9. (PMID:29100095)
- Myopia (HP:0000545): An abnormality of refraction characterized by the ability to see objects nearby clearly, while objects in the distance appear blurry. Evidence: PCS. Frequency: 4/10. (PMID:29100095)
- Tremor (HP:0001337): An unintentional, oscillating to-and-fro muscle movement about a joint axis. Evidence: PCS. Frequency: 5/10. (PMID:29100095)